Phenotypes associated with the disease Poland syndrome (OMIM:173800):
- Dextrocardia (HP:0001651): The heart is located in the right hand sided hemithorax. That is, there is a left-right reversal (or "mirror reflection") of the anatomical location of the heart in which the heart is locate on the right side instead of the left. Evidence: IEA. (OMIM:173800)
- Unilateral absence of pectoralis major muscle (HP:0005256): Aplasia (congenital absence) of the pectoralis minor on only one side of the chest. Evidence: TAS. (OMIM:173800)
- Absence of pectoralis minor muscle (HP:0005255): Aplasia (congenital absence) of the pectoralis minor. Evidence: TAS. (OMIM:173800)
- Unilateral hypoplasia of pectoralis major muscle (HP:0011959): Hypoplasia (underdevelopment) of the pectoralis minor on only one side of the chest. Evidence: TAS. (OMIM:173800)
- Rib fusion (HP:0000902): Complete or partial merging of adjacent ribs. Evidence: IEA. (OMIM:173800)
- Hypoplasia of serratus anterior muscle (HP:0009011): Underdevelopment of the serratus anterior muscle, which is involved in abduction, upward Rotation, and elevation of the scapula. Evidence: IEA. (OMIM:173800)
- Hemivertebrae (HP:0002937): Absence of one half of the vertebral body. Evidence: IEA. (OMIM:173800)
- Unilateral oligodactyly (HP:0006230). Evidence: IEA. (OMIM:173800)
- Hypoplasia of deltoid muscle (HP:0030241): Underdevelopment of the deltoid muscle. Evidence: IEA. (OMIM:173800)
- Hypoplasia of latissimus dorsi muscle (HP:0009026): Underdevelopment of the latissimus dorsi muscle, which is involved in adduction, extension, internal rotation, and transverse extension of the shoulder and assists in movement of the scapula. Evidence: IEA. (OMIM:173800)
- Abnormality of the breast (HP:0000769): An abnormality of the breast. Evidence: IEA. (OMIM:173800)
- Sprengel anomaly (HP:0000912): A congenital skeletal deformity characterized by the elevation of one scapula (thus, one scapula is located superior to the other). Evidence: IEA. (OMIM:173800)
- Syndactyly (HP:0001159): Webbing or fusion of the fingers or toes, involving soft parts only or including bone structure. Bony fusions are referred to as "bony" syndactyly if the fusion occurs in a radio-ulnar axis. Fusions of bones of the fingers or toes in a proximo-distal axis are referred to as "symphalangism". Evidence: IEA. (OMIM:173800)
- Short ribs (HP:0000773): Reduced rib length. Evidence: IEA. (OMIM:173800)
- Autosomal dominant inheritance (HP:0000006): A mode of inheritance that is observed for traits related to a gene encoded on one of the autosomes (i.e., the human chromosomes 1-22) in which a trait manifests in heterozygotes. In the context of medical genetics, an autosomal dominant disorder is caused when a single copy of the mutant allele is present. Males and females are affected equally, and can both transmit the disorder with a risk of 50% for each child of inheriting the mutant allele. Evidence: IEA. (OMIM:173800)
- Unilateral brachydactyly (HP:0006008). Evidence: IEA. (OMIM:173800)